- Abnormality of the genitourinary system (HP:0000119): The presence of any abnormality of the genitourinary system. Evidence: IEA. (OMIM:305690)
- X-linked inheritance (HP:0001417): A mode of inheritance that is observed for traits related to a gene encoded on the X chromosome. Evidence: IEA. (OMIM:305690)
- Neonatal death (HP:0003811): Death within the first 28 days of life. Evidence: IEA. (OMIM:305690)
These phenotypes are associated with the disease Genitourinary tract anomalies (OMIM:305690).